- Ventricular fibrillation (HP:0001663, a Human Phenotype Ontology term): Uncontrolled contractions of muscles fibers in the left ventricle not producing contraction of the left ventricle. Ventricular fibrillation usually begins with a ventricular premature contraction and a short run of rapid ventricular tachycardia degenerating into uncoordinating ventricular fibrillations. Evidence: TAS. (OMIM:603829)
- Tachycardia (HP:0001649, a Human Phenotype Ontology term): A rapid heartrate that exceeds the range of the normal resting heartrate for age. Evidence: PCS. (PMID:4834245)
- Syncope (HP:0001279, a Human Phenotype Ontology term): A transient loss of consciousness (i.e., characterized by a rapid onset, a short duration, and a spontaneous and complete recovery) due to cerebral hypoperfusion. Evidence: PCS. (PMID:4834245)
These phenotypes are associated with the disease ventricular fibrillation, paroxysmal familial, type 1 (OMIM:603829, an entry in Online Mendelian Inheritance in Man).